- Cataract (HP:0000518): A cataract is an opacity or clouding that develops in the crystalline lens of the eye or in its capsule. Evidence: TAS. Frequency: Very frequent (HP:0040281). (ORPHA:35664)
- Hyperextensible skin (HP:0000974): A condition in which the skin can be stretched beyond normal, and then returns to its initial position. Evidence: TAS. Frequency: Very frequent (HP:0040281). (ORPHA:35664)
- Intellectual disability (HP:0001249): The term intellectual disability or intellectual developmental disorder is used to describe significantly sub-average intellectual and adaptive functioning based on clinical assessment and as measured by individually administered, appropriately normed, standardized and validated tests of intellectual functioning and adaptive behavior, with onset during the developmental period from infancy through adolescence. Evidence: TAS. Frequency: Very frequent (HP:0040281). (ORPHA:35664)
- Global developmental delay (HP:0001263): A delay in the achievement of motor or mental milestones in the domains of development of a child, including motor skills, speech and language, cognitive skills, and social and emotional skills. This term should only be used to describe children younger than five years of age. Evidence: TAS. Frequency: Very frequent (HP:0040281). (ORPHA:35664)
- Joint hypermobility (HP:0001382): The capability that a joint (or a group of joints) has to move, passively and/or actively, beyond normal limits along physiological axes. Evidence: TAS. Frequency: Very frequent (HP:0040281). (ORPHA:35664)
These phenotypes are associated with the disease ALDH18A1-related De Barsy syndrome (ORPHA:35664).